Phenotypes associated with the disease hereditary papillary renal cell carcinoma (OMIM:605074):
- Typified by somatic mosaicism (HP:0001442): Description of conditions in which affected individuals typically display somatic mosaicism, i.e., genetically distinct populations of somatic cells in a given organism caused by DNA mutations, epigenetic alterations of DNA, chromosomal abnormalities or the spontaneous reversion of inherited mutations. In many conditions typified by somatic mosaicism, constitutive mutation is lethal and cases are exclusively or predominantly mosaic. Evidence: PCS. (PMID:9140397)
- Typified by incomplete penetrance (HP:0003829): Description of conditions in which not all individuals with a given genotype exhibit the disease. Penetrance is the proportion that develop disease given a lifespan of 80 years. Evidence: PCS. (PMID:9140397)
- Papillary renal cell carcinoma (HP:0006766): The presence of renal cell carcinoma in the renal papilla. Evidence: PCS. (PMID:9140397)
- Autosomal dominant inheritance (HP:0000006): A mode of inheritance that is observed for traits related to a gene encoded on one of the autosomes (i.e., the human chromosomes 1-22) in which a trait manifests in heterozygotes. In the context of medical genetics, an autosomal dominant disorder is caused when a single copy of the mutant allele is present. Males and females are affected equally, and can both transmit the disorder with a risk of 50% for each child of inheriting the mutant allele. Evidence: PCS. (PMID:9140397)